Phenotypes associated with the disease Coffin-Siris syndrome (ORPHA:1465):
- Joint hypermobility (HP:0001382): The capability that a joint (or a group of joints) has to move, passively and/or actively, beyond normal limits along physiological axes. Evidence: TAS. Frequency: Frequent (HP:0040282). (ORPHA:1465)
- Prominent eyelashes (HP:0011231): Eyelashes that draw the attention of the viewer due to increased density and/or length and/or curl without meeting the criteria of trichomegaly. Evidence: TAS. Frequency: Very frequent (HP:0040281). (ORPHA:1465)
- Feeding difficulties (HP:0011968): Impaired ability to eat related to problems gathering food and getting ready to suck, chew, or swallow it. Evidence: TAS. Frequency: Very frequent (HP:0040281). (ORPHA:1465)
- Cryptorchidism (HP:0000028): Testis in inguinal canal. That is, absence of one or both testes from the scrotum owing to failure of the testis or testes to descend through the inguinal canal to the scrotum. Evidence: TAS. Frequency: Frequent (HP:0040282). (ORPHA:1465)
- Abnormality of the genitourinary system (HP:0000119): The presence of any abnormality of the genitourinary system. Evidence: TAS. Frequency: Frequent (HP:0040282). (ORPHA:1465)
- Thin upper lip vermilion (HP:0000219): Height of the vermilion of the upper lip in the midline more than 2 SD below the mean. Alternatively, an apparently reduced height of the vermilion of the upper lip in the frontal view (subjective). Evidence: TAS. Frequency: Frequent (HP:0040282). (ORPHA:1465)
- Broad philtrum (HP:0000289): Distance between the philtral ridges, measured just above the vermilion border, more than 2 standard deviations above the mean, or alternatively, an apparently increased distance between the ridges of the philtrum. Evidence: TAS. Frequency: Frequent (HP:0040282). (ORPHA:1465)
- Low anterior hairline (HP:0000294): Distance between the hairline (trichion) and the glabella (the most prominent point on the frontal bone above the root of the nose), in the midline, more than two SD below the mean. Alternatively, an apparently decreased distance between the hairline and the glabella. Evidence: TAS. Frequency: Frequent (HP:0040282). (ORPHA:1465)
- Hearing impairment (HP:0000365): A decreased magnitude of the sensory perception of sound. Evidence: TAS. Frequency: Frequent (HP:0040282). (ORPHA:1465)
- Broad nasal tip (HP:0000455): Increase in width of the nasal tip. Evidence: TAS. Frequency: Frequent (HP:0040282). (ORPHA:1465)
- Anteverted nares (HP:0000463): Anteriorly-facing nostrils viewed with the head in the Frankfurt horizontal and the eyes of the observer level with the eyes of the subject. This gives the appearance of an upturned nose (upturned nasal tip). Evidence: TAS. Frequency: Frequent (HP:0040282). (ORPHA:1465)
- Strabismus (HP:0000486): A misalignment of the eyes so that the visual axes deviate from bifoveal fixation. The classification of strabismus may be based on a number of features including the relative position of the eyes, whether the deviation is latent or manifest, intermittent or constant, concomitant or otherwise and according to the age of onset and the relevance of any associated refractive error. Evidence: TAS. Frequency: Frequent (HP:0040282). (ORPHA:1465)
- Visual impairment (HP:0000505): Visual impairment (or vision impairment) is vision loss (of a person) to such a degree as to qualify as an additional support need through a significant limitation of visual capability resulting from either disease, trauma, or congenital or degenerative conditions that cannot be corrected by conventional means, such as refractive correction, medication, or surgery. Evidence: TAS. Frequency: Frequent (HP:0040282). (ORPHA:1465)
- Ptosis (HP:0000508): The upper eyelid margin is positioned 3 mm or more lower than usual and covers the superior portion of the iris (objective); or, the upper lid margin obscures at least part of the pupil (subjective). Evidence: TAS. Frequency: Frequent (HP:0040282). (ORPHA:1465)
- Delayed eruption of teeth (HP:0000684): Delayed tooth eruption, which can be defined as tooth eruption more than 2 SD beyond the mean eruption age. Evidence: TAS. Frequency: Frequent (HP:0040282). (ORPHA:1465)
- Atypical behavior (HP:0000708): Atypical behavior is an abnormality in a person's actions that can be controlled or modulated by the will of the individual. While abnormal behaviors can be difficult to control, they are distinct from other abnormal actions that cannot be affected by the individual's will. Evidence: TAS. Frequency: Frequent (HP:0040282). (ORPHA:1465)
- Hirsutism (HP:0001007): Abnormally increased hair growth referring to a male pattern of body hair (androgenic hair). Evidence: TAS. Frequency: Frequent (HP:0040282). (ORPHA:1465)
- Seizure (HP:0001250): A seizure is an intermittent abnormality of nervous system physiology characterized by a transient occurrence of signs and/or symptoms due to abnormal excessive or synchronous neuronal activity in the brain. Evidence: TAS. Frequency: Frequent (HP:0040282). (ORPHA:1465)
- Growth delay (HP:0001510): A deficiency or slowing down of growth pre- and postnatally. Evidence: TAS. Frequency: Frequent (HP:0040282). (ORPHA:1465)
- Abnormal heart morphology (HP:0001627): Any structural anomaly of the heart. Evidence: TAS. Frequency: Frequent (HP:0040282). (ORPHA:1465)
- Abnormal facial shape (HP:0001999): An abnormal morphology (form) of the face or its components. Evidence: TAS. Frequency: Frequent (HP:0040282). (ORPHA:1465)
- Sparse scalp hair (HP:0002209): Decreased number of hairs per unit area of skin of the scalp. Evidence: TAS. Frequency: Frequent (HP:0040282). (ORPHA:1465)
- Moderate intellectual disability (HP:0002342): Moderate intellectual disability (ID) is defined as a type of ID characterized by moderately sub-average adaptive functioning and intellectual functioning, with an intelligence quotient (IQ) the range of 35-49. Evidence: TAS. Frequency: Frequent (HP:0040282). (ORPHA:1465)
- Scoliosis (HP:0002650): The presence of an abnormal lateral curvature of the spine. Evidence: TAS. Frequency: Frequent (HP:0040282). (ORPHA:1465)
- Recurrent infections (HP:0002719): Increased susceptibility to infections as manifested by repeated bouts of infection. Evidence: TAS. Frequency: Frequent (HP:0040282). (ORPHA:1465)
- Delayed skeletal maturation (HP:0002750): A decreased rate of skeletal maturation. Delayed skeletal maturation can be diagnosed on the basis of an estimation of the bone age from radiographs of specific bones in the human body. Evidence: TAS. Frequency: Frequent (HP:0040282). (ORPHA:1465)
- Recurrent upper respiratory tract infections (HP:0002788): An increased susceptibility to upper respiratory tract infections as manifested by a history of recurrent upper respiratory tract infections (running ears - otitis, sinusitis, pharyngitis, tonsillitis). Evidence: TAS. Frequency: Frequent (HP:0040282). (ORPHA:1465)
- Short nose (HP:0003196): Distance from nasion to subnasale more than two standard deviations below the mean, or alternatively, an apparently decreased length from the nasal root to the nasal tip. Evidence: TAS. Frequency: Frequent (HP:0040282). (ORPHA:1465)
- Depressed nasal bridge (HP:0005280): Posterior positioning of the nasal root in relation to the overall facial profile for age. Evidence: TAS. Frequency: Frequent (HP:0040282). (ORPHA:1465)
- Hypoplastic fifth fingernail (HP:0008398): A nail of the fifth finger that is diminished in length and width, i.e., underdeveloped nail of little finger. Evidence: TAS. Frequency: Frequent (HP:0040282). (ORPHA:1465)
- Postnatal growth retardation (HP:0008897): Slow or limited growth after birth. Evidence: TAS. Frequency: Frequent (HP:0040282). (ORPHA:1465)
- Floppy infant (HP:0008947): Floppiness/hypotonia is defined as reduced resistance to passive movement of joints. Physical examination of floppy/hypotonic infants shows head lag, lack of shoulder and elbow muscle contraction on traction response, inability to tighten the shoulder girdle muscles (or slipping through) when held under the axillae, scarf sign (when the arm is pulled to the opposite side, the arm wraps around the neck with the elbow crossing midline), hyperdorsiflexion of the feet, easy apposition of the thumb against the forearm, feet touching the cheek with ease and without discomfort, frog leg position, and inverted U sign on ventral suspension (head, arms, and legs hanging down without elbow or knee flexion and the trunk rounded in a dome shape). Evidence: TAS. Frequency: Frequent (HP:0040282). (ORPHA:1465)
- Short 5th finger (HP:0009237): Hypoplasia (congenital reduction in size) of the fifth finger, also known as the little finger. Evidence: TAS. Frequency: Frequent (HP:0040282). (ORPHA:1465)
- Thick nasal alae (HP:0009928): Increase in bulk of the ala nasi. Evidence: TAS. Frequency: Frequent (HP:0040282). (ORPHA:1465)
- Severe intellectual disability (HP:0010864): Severe intellectual disability (ID) is defined as a type of ID characterized by severely sub-average adaptive functioning and intellectual functioning, with an intelligence quotient (IQ) the range of 20-34. Evidence: TAS. Frequency: Frequent (HP:0040282). (ORPHA:1465)
- Hypoplastic fifth toenail (HP:0011937): Underdeveloped nails of the fifth toes. Evidence: TAS. Frequency: Frequent (HP:0040282). (ORPHA:1465)
- Aspiration pneumonia (HP:0011951): Pneumonia due to the aspiration (breathing in) of food, liquid, or gastric contents into the upper respiratory tract. Evidence: TAS. Frequency: Frequent (HP:0040282). (ORPHA:1465)
- Wide nasal base (HP:0012810): Increased distance between the attachments of the alae nasi to the face. Evidence: TAS. Frequency: Frequent (HP:0040282). (ORPHA:1465)
- Clinodactyly (HP:0030084): An angulation of a digit at an interphalangeal joint in the plane of the palm (finger) or sole (toe). Evidence: TAS. Frequency: Frequent (HP:0040282). (ORPHA:1465)
- Hypospadias (HP:0000047): Abnormal position of urethral meatus on the ventral penile shaft (underside) characterized by displacement of the urethral meatus from the tip of the glans penis to the ventral surface of the penis, scrotum, or perineum. Evidence: TAS. Frequency: Occasional (HP:0040283). (ORPHA:1465)
- Horseshoe kidney (HP:0000085): A connection of the right and left kidney by an isthmus of functioning renal parenchyma or fibrous tissue that crosses the midline. Evidence: TAS. Frequency: Occasional (HP:0040283). (ORPHA:1465)
- Myopia (HP:0000545): An abnormality of refraction characterized by the ability to see objects nearby clearly, while objects in the distance appear blurry. Evidence: TAS. Frequency: Occasional (HP:0040283). (ORPHA:1465)
- Aggressive behavior (HP:0000718): Behavior or an act aimed at harming a person, animal, or physical property (e.g., acts of physical violence; shouting, swearing, and using harsh language; slashing someone's tires). Evidence: TAS. Frequency: Occasional (HP:0040283). (ORPHA:1465)
- Autistic behavior (HP:0000729): Persistent deficits in social interaction and communication and interaction as well as a markedly restricted repertoire of activity and interest as well as repetitive patterns of behavior. Evidence: TAS. Frequency: Occasional (HP:0040283). (ORPHA:1465)
- Hyperactivity (HP:0000752): Hyperactivity is a condition characterized by constant and unusually high levels of activity, even in situations where it is deemed inappropriate. Evidence: TAS. Frequency: Occasional (HP:0040283). (ORPHA:1465)
- Agenesis of corpus callosum (HP:0001274): Absence of the corpus callosum as a result of the failure of the corpus callosum to develop, which can be the result of a failure in any one of the multiple steps of callosal development including cellular proliferation and migration, axonal growth or glial patterning at the midline. Evidence: TAS. Frequency: Occasional (HP:0040283). (ORPHA:1465)
- Dandy-Walker malformation (HP:0001305): A congenital brain malformation typically characterized by incomplete formation of the cerebellar vermis, dilation of the fourth ventricle, and enlargement of the posterior fossa. In layman's terms, Dandy Walker malformation is a cyst in the cerebellum (typically symmetrical) that is involved with the fourth ventricle. This may interfere with the ability to drain cerebrospinal fluid from the brain, resulting in hydrocephalus. Dandy Walker cysts are formed during early embryonic development, while the brain forms. The cyst in the cerebellum typically has several blood vessels running through it connecting to the brain, thereby prohibiting surgical removal. Evidence: TAS. Frequency: Occasional (HP:0040283). (ORPHA:1465)
- Absent speech (HP:0001344): Complete lack of development of speech and language abilities. Evidence: TAS. Frequency: Occasional (HP:0040283). (ORPHA:1465)
- Ventricular septal defect (HP:0001629): A hole between the two bottom chambers (ventricles) of the heart. The defect is centered around the most superior aspect of the ventricular septum. Evidence: TAS. Frequency: Occasional (HP:0040283). (ORPHA:1465)
- Atrial septal defect (HP:0001631): Atrial septal defect (ASD) is a congenital abnormality of the interatrial septum that enables blood flow between the left and right atria via the interatrial septum. Evidence: TAS. Frequency: Occasional (HP:0040283). (ORPHA:1465)
- Tetralogy of Fallot (HP:0001636): A congenital cardiac malformation comprising pulmonary stenosis, overriding aorta, ventricular septum defect, and right ventricular hypertrophy. The diagnosis of TOF is made if at least three of the four above mentioned features are present. Evidence: TAS. Frequency: Occasional (HP:0040283). (ORPHA:1465)
- Patent ductus arteriosus (HP:0001643): In utero, the ductus arteriosus (DA) serves to divert ventricular output away from the lungs and toward the placenta by connecting the main pulmonary artery to the descending aorta. A patent ductus arteriosus (PDA) in the first 3 days of life is a physiologic shunt in healthy term and preterm newborn infants, and normally is substantially closed within about 24 hours after bith and completely closed after about three weeks. Failure of physiologcal closure is referred to a persistent or patent ductus arteriosus (PDA). Depending on the degree of left-to-right shunting, PDA can have clinical consequences. Evidence: TAS. Frequency: Occasional (HP:0040283). (ORPHA:1465)
- Simplified gyral pattern (HP:0009879): An abnormality of the cerebral cortex with fewer gyri but with normal cortical thickness. This pattern is usually often associated with congenital microcephaly. Evidence: TAS. Frequency: Occasional (HP:0040283). (ORPHA:1465)
- Oral aversion (HP:0012523): Reluctance or refusal of a child to be breastfed or eat, manifested as gagging, vomiting, turning head away from food, or avoidance of sensation in or around the mouth (i.e. toothbrushing or face-washing). Evidence: TAS. Frequency: Occasional (HP:0040283). (ORPHA:1465)
- Hernia (HP:0100790). Evidence: TAS. Frequency: Occasional (HP:0040283). (ORPHA:1465)
- Microcephaly (HP:0000252): Head circumference below 2 standard deviations below the mean for age and gender. Evidence: TAS. Frequency: Very rare (HP:0040284). (ORPHA:1465)
- Intrauterine growth retardation (HP:0001511): An abnormal restriction of fetal growth with fetal weight below the tenth percentile for gestational age. Evidence: TAS. Frequency: Very rare (HP:0040284). (ORPHA:1465)
- Hepatoblastoma (HP:0002884): A kind of neoplasm of the liver that originates from immature liver precursor cells and macroscopically is composed of tissue resembling fetal or mature liver cells or bile ducts. Evidence: TAS. Frequency: Very rare (HP:0040284). (ORPHA:1465)
- Papillary thyroid carcinoma (HP:0002895): The presence of a papillary adenocarcinoma of the thyroid gland. Evidence: TAS. Frequency: Very rare (HP:0040284). (ORPHA:1465)
- Wide mouth (HP:0000154): Distance between the oral commissures more than 2 SD above the mean. Alternatively, an apparently increased width of the oral aperture (subjective). Evidence: TAS. Frequency: Very frequent (HP:0040281). (ORPHA:1465)
- Thick lower lip vermilion (HP:0000179): Increased thickness of the lower lip, leading to a prominent appearance of the lower lip. The height of the vermilion of the lower lip in the midline is more than 2 SD above the mean. Alternatively, an apparently increased height of the vermilion of the lower lip in the frontal view (subjective). Evidence: TAS. Frequency: Very frequent (HP:0040281). (ORPHA:1465)
- Coarse facial features (HP:0000280): Absence of fine and sharp appearance of brows, nose, lips, mouth, and chin, usually because of rounded and heavy features or thickened skin with or without thickening of subcutaneous and bony tissues. Evidence: TAS. Frequency: Very frequent (HP:0040281). (ORPHA:1465)
- Thick eyebrow (HP:0000574): Increased density/number and/or increased diameter of eyebrow hairs. Evidence: TAS. Frequency: Very frequent (HP:0040281). (ORPHA:1465)
- Hypertrichosis (HP:0000998): Hypertrichosis is increased hair growth that is abnormal in quantity or location. Evidence: TAS. Frequency: Very frequent (HP:0040281). (ORPHA:1465)
- Small nail (HP:0001792): A nail that is diminished in length and width, i.e., underdeveloped nail. Evidence: TAS. Frequency: Very frequent (HP:0040281). (ORPHA:1465)